Phenotypes associated with the disease Gilbert syndrome (OMIM:143500):
- Unconjugated hyperbilirubinemia (HP:0008282): An increased amount of unconjugated (indirect) bilurubin in the blood. Evidence: PCS. Frequency: 20/20. (PMID:11316168)
- Hepatic failure (HP:0001399). Evidence: PCS. Frequency: 0/20. (PMID:11316168)
- Autosomal recessive inheritance (HP:0000007): A mode of inheritance that is observed for traits related to a gene encoded on one of the autosomes (i.e., the human chromosomes 1-22) in which a trait manifests in individuals with two pathogenic alleles, either homozygotes (two copies of the same mutant allele) or compound heterozygotes (whereby each copy of a gene has a distinct mutant allele). Evidence: PCS. (PMID:10412811)
- Elevated circulating hepatic transaminase concentration (HP:0002910): Elevations of the levels of SGOT and SGPT in the serum. SGOT (serum glutamic oxaloacetic transaminase) and SGPT (serum glutamic pyruvic transaminase) are transaminases primarily found in the liver and heart and are released into the bloodstream as the result of liver or heart damage. SGOT and SGPT are used clinically mainly as markers of liver damage. Evidence: PCS. Frequency: 0/20. (PMID:11316168)
- Jaundice (HP:0000952): Yellow pigmentation of the skin due to bilirubin, which in turn is the result of increased bilirubin concentration in the bloodstream. Evidence: IEA. (OMIM:143500)